Phenotypes associated with the disease Cystic hamartoma of lung and kidney (ORPHA:2111):
- Multicystic kidney dysplasia (HP:0000003): Multicystic dysplasia of the kidney is characterized by multiple cysts of varying size in the kidney and the absence of a normal pelvicaliceal system. The condition is associated with ureteral or ureteropelvic atresia, and the affected kidney is nonfunctional. Evidence: TAS. Frequency: Very frequent (HP:0040281). (ORPHA:2111)
- Hypertension (HP:0000822): The presence of chronic increased pressure in the systemic arterial system. Evidence: TAS. Frequency: Very frequent (HP:0040281). (ORPHA:2111)
- Respiratory insufficiency (HP:0002093). Evidence: TAS. Frequency: Frequent (HP:0040282). (ORPHA:2111)
- Recurrent respiratory infections (HP:0002205): An increased susceptibility to respiratory infections as manifested by a history of recurrent respiratory infections. Evidence: TAS. Frequency: Frequent (HP:0040282). (ORPHA:2111)
- Pulmonary fibrosis (HP:0002206): Replacement of normal lung tissues by fibroblasts and collagen. Evidence: TAS. Frequency: Very frequent (HP:0040281). (ORPHA:2111)